Phenotypes associated with the disease White forelock with malformations (ORPHA:2475):
- Joint hypermobility (HP:0001382): The capability that a joint (or a group of joints) has to move, passively and/or actively, beyond normal limits along physiological axes. Evidence: TAS. Frequency: Very frequent (HP:0040281). (ORPHA:2475)
- Posteriorly rotated ears (HP:0000358): A type of abnormal location of the ears in which the position of the ears is characterized by posterior rotation (the superior part of the ears is rotated towards the back of the head, and the inferior part of the ears towards the front). Evidence: TAS. Frequency: Very frequent (HP:0040281). (ORPHA:2475)
- Abnormal palate morphology (HP:0000174): Any abnormality of the palate, i.e., of roof of the mouth. Evidence: TAS. Frequency: Very frequent (HP:0040281). (ORPHA:2475)
- Dolichocephaly (HP:0000268): An abnormality of skull shape characterized by a increased anterior-posterior diameter, i.e., an increased antero-posterior dimension of the skull. Cephalic index less than 76%. Alternatively, an apparently increased antero-posterior length of the head compared to width. Often due to premature closure of the sagittal suture. Evidence: TAS. Frequency: Very frequent (HP:0040281). (ORPHA:2475)
- Epicanthus (HP:0000286): A fold of skin starting above the medial aspect of the upper eyelid and arching downward to cover, pass in front of and lateral to the medial canthus. Evidence: TAS. Frequency: Very frequent (HP:0040281). (ORPHA:2475)
- Hypertelorism (HP:0000316): Interpupillary distance more than 2 SD above the mean (alternatively, the appearance of an increased interpupillary distance or widely spaced eyes). Evidence: TAS. Frequency: Very frequent (HP:0040281). (ORPHA:2475)
- Blue sclerae (HP:0000592): An abnormal bluish coloration of the sclera. Evidence: TAS. Frequency: Very frequent (HP:0040281). (ORPHA:2475)
- Atrial septal defect (HP:0001631): Atrial septal defect (ASD) is a congenital abnormality of the interatrial septum that enables blood flow between the left and right atria via the interatrial septum. Evidence: TAS. Frequency: Very frequent (HP:0040281). (ORPHA:2475)
- Deep philtrum (HP:0002002): Accentuated, prominent philtral ridges giving rise to an exaggerated groove in the midline between the nasal base and upper vermillion border. Evidence: TAS. Frequency: Very frequent (HP:0040281). (ORPHA:2475)
- Abnormality of the respiratory system (HP:0002086): An abnormality of the respiratory system, which include the airways, lungs, and the respiratory muscles. Evidence: TAS. Frequency: Very frequent (HP:0040281). (ORPHA:2475)
- White forelock (HP:0002211): A triangular depigmented region of white hairs located in the anterior midline of the scalp. Evidence: TAS. Frequency: Very frequent (HP:0040281). (ORPHA:2475)
- Delayed skeletal maturation (HP:0002750): A decreased rate of skeletal maturation. Delayed skeletal maturation can be diagnosed on the basis of an estimation of the bone age from radiographs of specific bones in the human body. Evidence: TAS. Frequency: Very frequent (HP:0040281). (ORPHA:2475)
- Clinodactyly of the 5th finger (HP:0004209): Clinodactyly refers to a bending or curvature of the fifth finger in the radial direction (i.e., towards the 4th finger). Evidence: TAS. Frequency: Very frequent (HP:0040281). (ORPHA:2475)
- Finger syndactyly (HP:0006101): Webbing or fusion of the fingers, involving soft parts only or including bone structure. Bony fusions are referred to as "bony" Syndactyly if the fusion occurs in a radio-ulnar axis. Fusions of bones of the fingers in a proximo-distal axis are referred to as "Symphalangism". Evidence: TAS. Frequency: Very frequent (HP:0040281). (ORPHA:2475)
- Strabismus (HP:0000486): A misalignment of the eyes so that the visual axes deviate from bifoveal fixation. The classification of strabismus may be based on a number of features including the relative position of the eyes, whether the deviation is latent or manifest, intermittent or constant, concomitant or otherwise and according to the age of onset and the relevance of any associated refractive error. Evidence: TAS. Frequency: Frequent (HP:0040282). (ORPHA:2475)
- Myopia (HP:0000545): An abnormality of refraction characterized by the ability to see objects nearby clearly, while objects in the distance appear blurry. Evidence: TAS. Frequency: Frequent (HP:0040282). (ORPHA:2475)
- Abnormal rib morphology (HP:0000772): An anomaly of the rib. Evidence: TAS. Frequency: Frequent (HP:0040282). (ORPHA:2475)
- Sprengel anomaly (HP:0000912): A congenital skeletal deformity characterized by the elevation of one scapula (thus, one scapula is located superior to the other). Evidence: TAS. Frequency: Frequent (HP:0040282). (ORPHA:2475)
- Spina bifida occulta (HP:0003298): The closed form of spina bifida with incomplete closure of a vertebral body with intact overlying skin. Evidence: TAS. Frequency: Frequent (HP:0040282). (ORPHA:2475)